- Bradykinesia (HP:0002067): Bradykinesia literally means slow movement, and is used clinically to denote a slowness in the execution of movement (in contrast to hypokinesia, which is used to refer to slowness in the initiation of movement). Evidence: PCS. (PMID:15961413)
- Rigidity (HP:0002063): Continuous involuntary sustained muscle contraction. When an affected muscle is passively stretched, the degree of resistance remains constant regardless of the rate at which the muscle is stretched. This feature helps to distinguish rigidity from muscle spasticity. Evidence: PCS. (PMID:15961413)
- Parkinsonism with favorable response to dopaminergic medication (HP:0002548): Parkinsonism is a clinical syndrome that is a feature of a number of different diseases, including Parkinson disease itself, other neurodegenerative diseases such as progressive supranuclear palsy, and as a side-effect of some neuroleptic medications. Some but not all individuals with Parkinsonism show responsiveness to dopaminergic medication defined as a substantial reduction of amelioration of the component signs of Parkinsonism (including mainly tremor, bradykinesia, rigidity, and postural instability) upon administration of dopaminergic medication. Evidence: PCS. Onset: Middle age onset (HP:0003596). (PMID:15961413)
- Autosomal dominant inheritance (HP:0000006): A mode of inheritance that is observed for traits related to a gene encoded on one of the autosomes (i.e., the human chromosomes 1-22) in which a trait manifests in heterozygotes. In the context of medical genetics, an autosomal dominant disorder is caused when a single copy of the mutant allele is present. Males and females are affected equally, and can both transmit the disorder with a risk of 50% for each child of inheriting the mutant allele. Evidence: PCS. (PMID:15961413)
- Tremor (HP:0001337): An unintentional, oscillating to-and-fro muscle movement about a joint axis. Evidence: PCS. (PMID:15961413)
These phenotypes are associated with the disease Parkinson disease 13, autosomal dominant, susceptibility to (OMIM:610297).